- Hypermelanotic macule (HP:0001034): A hyperpigmented circumscribed area of change in normal skin color without elevation or depression of any size. Evidence: IEA. (OMIM:139650)
- Autosomal dominant inheritance (HP:0000006): A mode of inheritance that is observed for traits related to a gene encoded on one of the autosomes (i.e., the human chromosomes 1-22) in which a trait manifests in heterozygotes. In the context of medical genetics, an autosomal dominant disorder is caused when a single copy of the mutant allele is present. Males and females are affected equally, and can both transmit the disorder with a risk of 50% for each child of inheriting the mutant allele. Evidence: IEA. (OMIM:139650)
These phenotypes are associated with the disease hairy palms and soles (OMIM:139650).